Phenotypes associated with the disease dandy-walker malformation with occipital cephalocele, autosomal dominant (OMIM:609222):
- Macrocephaly at birth (HP:0004488): The presence of an abnormally large skull with onset at birth. Evidence: TAS. (OMIM:609222)
- Typified by incomplete penetrance (HP:0003829): Description of conditions in which not all individuals with a given genotype exhibit the disease. Penetrance is the proportion that develop disease given a lifespan of 80 years. Evidence: TAS. (OMIM:609222)
- Dandy-Walker malformation (HP:0001305): A congenital brain malformation typically characterized by incomplete formation of the cerebellar vermis, dilation of the fourth ventricle, and enlargement of the posterior fossa. In layman's terms, Dandy Walker malformation is a cyst in the cerebellum (typically symmetrical) that is involved with the fourth ventricle. This may interfere with the ability to drain cerebrospinal fluid from the brain, resulting in hydrocephalus. Dandy Walker cysts are formed during early embryonic development, while the brain forms. The cyst in the cerebellum typically has several blood vessels running through it connecting to the brain, thereby prohibiting surgical removal. Evidence: TAS. (OMIM:609222)
- Atretic occipital cephalocele (HP:0004470): A congenital defect in the occipital region of the skull, covered by skin of the scalp and containing meninges or remnants of glial or neural tissues. Evidence: TAS. (OMIM:609222)
- Autosomal dominant inheritance (HP:0000006): A mode of inheritance that is observed for traits related to a gene encoded on one of the autosomes (i.e., the human chromosomes 1-22) in which a trait manifests in heterozygotes. In the context of medical genetics, an autosomal dominant disorder is caused when a single copy of the mutant allele is present. Males and females are affected equally, and can both transmit the disorder with a risk of 50% for each child of inheriting the mutant allele. Evidence: TAS. (OMIM:609222)